- Developmental cataract (HP:0000519): A cataract that occurs congenitally as the result of a developmental defect, in contrast to the majority of cataracts that occur in adulthood as the result of degenerative changes of the lens. Evidence: PCS. (PMID:10739768)
- Autosomal dominant inheritance (HP:0000006): A mode of inheritance that is observed for traits related to a gene encoded on one of the autosomes (i.e., the human chromosomes 1-22) in which a trait manifests in heterozygotes. In the context of medical genetics, an autosomal dominant disorder is caused when a single copy of the mutant allele is present. Males and females are affected equally, and can both transmit the disorder with a risk of 50% for each child of inheriting the mutant allele. Evidence: TAS. (OMIM:611597)
- Myopia (HP:0000545): An abnormality of refraction characterized by the ability to see objects nearby clearly, while objects in the distance appear blurry. Evidence: TAS. (OMIM:611597)
- Progressive cataract (HP:0007834): A kind of cataract that progresses with age. Evidence: TAS. (OMIM:611597)
These phenotypes are associated with the disease cataract 12 multiple types (OMIM:611597).